- Epicanthus (HP:0000286): A fold of skin starting above the medial aspect of the upper eyelid and arching downward to cover, pass in front of and lateral to the medial canthus. Evidence: PCS. Frequency: 1/3. (PMID:19764024)
- Microcephaly (HP:0000252): Head circumference below 2 standard deviations below the mean for age and gender. Evidence: PCS. Frequency: 3/3. (PMID:19764024)
- Upslanted palpebral fissure (HP:0000582): The palpebral fissure inclination is more than two standard deviations above the mean for age (objective); or, the inclination of the palpebral fissure is greater than typical for age. Evidence: PCS. Frequency: 3/3. (PMID:19764024)
- Scoliosis (HP:0002650): The presence of an abnormal lateral curvature of the spine. Evidence: PCS. Frequency: 2/3. (PMID:19764024)
- Wide nasal bridge (HP:0000431): Increased breadth of the nasal bridge (and with it, the nasal root). Evidence: PCS. Frequency: 2/3. (PMID:19764024)
- Short foot (HP:0001773): A measured foot length that is more than 2 SD below the mean for a newborn of 27 - 41 weeks gestation, or foot that is less than the 3rd centile for individuals from birth to 16 years of age (objective). Alternatively, a foot that appears disproportionately short (subjective). Evidence: PCS. Frequency: 1/3. (PMID:19764024)
- Short stature (HP:0004322): A height below that which is expected according to age and gender norms. Although there is no universally accepted definition of short stature, many refer to "short stature" as height more than 2 standard deviations below the mean for age and gender (or below the 3rd percentile for age and gender dependent norms). Evidence: PCS. Frequency: 1/3. (PMID:19764024)
- Underdeveloped nasal alae (HP:0000430): Thinned, deficient, or excessively arched ala nasi. Evidence: PCS. Frequency: 2/3. (PMID:19764024)
- Feeding difficulties (HP:0011968): Impaired ability to eat related to problems gathering food and getting ready to suck, chew, or swallow it. Evidence: PCS. Frequency: 2/3. (PMID:19764024)
- Hypotonia (HP:0001252): Hypotonia is an abnormally low muscle tone (the amount of tension or resistance to movement in a muscle). Even when relaxed, muscles have a continuous and passive partial contraction which provides some resistance to passive stretching. Hypotonia thus manifests as diminished resistance to passive stretching. Hypotonia is not the same as muscle weakness, although the two conditions can co-exist. Evidence: PCS. Frequency: 3/3. (PMID:19764024)
- Dermatographic urticaria (HP:0011971): An exaggerated whealing tendency when the skin is stroked, that is, formation of red, itchy bumps and lines on the skin as a result of pressure on the skin (for instance, stroking the skin with a pen or tongue depressor). Evidence: PCS. (PMID:19764024)
- Joint contracture of the 5th finger (HP:0009183): Chronic loss of joint motion in the 5th finger due to structural changes in non-bony tissue. The term camptodactyly of the 5th finger is used if the distal and/or proximal interphalangeal joints are affected. Evidence: PCS. Frequency: 1/3. (PMID:19764024)
- Childhood onset (HP:0011463): Onset of disease at the age of between 1 and 5 years. Evidence: PCS. (PMID:19764024)
- Microtia (HP:0008551): Underdevelopment of the external ear. Evidence: PCS. Frequency: 2/3. (PMID:19764024)
- Autosomal recessive inheritance (HP:0000007): A mode of inheritance that is observed for traits related to a gene encoded on one of the autosomes (i.e., the human chromosomes 1-22) in which a trait manifests in individuals with two pathogenic alleles, either homozygotes (two copies of the same mutant allele) or compound heterozygotes (whereby each copy of a gene has a distinct mutant allele). Evidence: PCS. (PMID:19764024)
- Conductive hearing impairment (HP:0000405): An abnormality of vibrational conductance of sound to the inner ear leading to impairment of sensory perception of sound. Evidence: PCS. Frequency: 3/3. (PMID:19764024)
- High palate (HP:0000218): Height of the palate more than 2 SD above the mean (objective) or palatal height at the level of the first permanent molar more than twice the height of the teeth (subjective). Evidence: PCS. Frequency: 3/3. (PMID:19764024)
- Clinodactyly of the 5th finger (HP:0004209): Clinodactyly refers to a bending or curvature of the fifth finger in the radial direction (i.e., towards the 4th finger). Evidence: PCS. Frequency: 2/3. (PMID:19764024)
- Intellectual disability (HP:0001249): The term intellectual disability or intellectual developmental disorder is used to describe significantly sub-average intellectual and adaptive functioning based on clinical assessment and as measured by individually administered, appropriately normed, standardized and validated tests of intellectual functioning and adaptive behavior, with onset during the developmental period from infancy through adolescence. Evidence: PCS. Frequency: 2/3. (PMID:19764024)
- Micrognathia (HP:0000347): Developmental hypoplasia of the mandible. Evidence: PCS. Frequency: 3/3. (PMID:19764024)
- Cutaneous mastocytosis (HP:0200151): Multifocal dense infiltrates of mast cells in cutaneous tissue. Evidence: PCS. Frequency: 3/3. (PMID:19764024)
These phenotypes are associated with the disease Hennekam-Beemer syndrome (OMIM:248910).